- Abnormal renal morphology (HP:0012210): Any structural anomaly of the kidney. Evidence: IEA. (OMIM:102520)
- Finger aplasia (HP:0009380): A developmental defect resulting in the presence of fewer than the normal number of fingers (i.e., aplasia of one or more fingers). Evidence: TAS. (OMIM:102520)
- Autosomal dominant inheritance (HP:0000006): A mode of inheritance that is observed for traits related to a gene encoded on one of the autosomes (i.e., the human chromosomes 1-22) in which a trait manifests in heterozygotes. In the context of medical genetics, an autosomal dominant disorder is caused when a single copy of the mutant allele is present. Males and females are affected equally, and can both transmit the disorder with a risk of 50% for each child of inheriting the mutant allele. Evidence: TAS. (OMIM:102520)
These phenotypes are associated with the disease acrorenal syndrome (OMIM:102520).